- Cryptorchidism (HP:0000028): Testis in inguinal canal. That is, absence of one or both testes from the scrotum owing to failure of the testis or testes to descend through the inguinal canal to the scrotum. Evidence: TAS. Frequency: Occasional (HP:0040283). (ORPHA:1555)
- Bifid scrotum (HP:0000048): Midline indentation or cleft of the scrotum. Evidence: TAS. Frequency: Frequent (HP:0040282). (ORPHA:1555)
- Narrow mouth (HP:0000160): Distance between the commissures of the mouth more than 2 SD below the mean. Alternatively, an apparently decreased width of the oral aperture (subjective). Evidence: TAS. Frequency: Occasional (HP:0040283). (ORPHA:1555)
- Cleft palate (HP:0000175): Cleft palate is a developmental defect of the palate resulting from a failure of fusion of the palatine processes and manifesting as a separation of the roof of the mouth (soft and hard palate). Evidence: TAS. Frequency: Occasional (HP:0040283). (ORPHA:1555)
- Narrow palate (HP:0000189): Width of the palate more than 2 SD below the mean (objective) or apparently decreased palatal width (subjective). Evidence: TAS. Frequency: Frequent (HP:0040282). (ORPHA:1555)
- Hydrocephalus (HP:0000238): Hydrocephalus is an active distension of the ventricular system of the brain resulting from inadequate passage of CSF from its point of production within the cerebral ventricles to its point of absorption into the systemic circulation. Evidence: TAS. Frequency: Occasional (HP:0040283). (ORPHA:1555)
- Turricephaly (HP:0000262): Tall head relative to width and length. Evidence: TAS. Frequency: Very frequent (HP:0040281). (ORPHA:1555)
- Dolichocephaly (HP:0000268): An abnormality of skull shape characterized by a increased anterior-posterior diameter, i.e., an increased antero-posterior dimension of the skull. Cephalic index less than 76%. Alternatively, an apparently increased antero-posterior length of the head compared to width. Often due to premature closure of the sagittal suture. Evidence: TAS. Frequency: Very frequent (HP:0040281). (ORPHA:1555)
- Abnormality of the face (HP:0000271): An abnormality of the face. Evidence: TAS. Frequency: Very frequent (HP:0040281). (ORPHA:1555)
- Malar flattening (HP:0000272): Underdevelopment of the malar prominence of the jugal bone (zygomatic bone in mammals), appreciated in profile, frontal view, and/or by palpation. Evidence: TAS. Frequency: Very frequent (HP:0040281). (ORPHA:1555)
- Hypertelorism (HP:0000316): Interpupillary distance more than 2 SD above the mean (alternatively, the appearance of an increased interpupillary distance or widely spaced eyes). Evidence: TAS. Frequency: Occasional (HP:0040283). (ORPHA:1555)
- Hearing abnormality (HP:0000364): An abnormality of the sensory perception of sound. Evidence: TAS. Frequency: Very frequent (HP:0040281). (ORPHA:1555)
- Thickened helices (HP:0000391): Increased thickness of the helix of the ear. Evidence: TAS. Frequency: Occasional (HP:0040283). (ORPHA:1555)
- Macrotia (HP:0000400): Median longitudinal ear length greater than two standard deviations above the mean and median ear width greater than two standard deviations above the mean (objective); or, apparent increase in length and width of the pinna (subjective). Evidence: TAS. Frequency: Very frequent (HP:0040281). (ORPHA:1555)
- Choanal atresia (HP:0000453): Absence or abnormal closure of the choana (the posterior nasal aperture). Most embryologists believe that posterior choanal atresia results from a failure of rupture between the 35th and 38th day of fetal life of the partition which separates the bucconasal or buccopharyngeal membranes. The resultant choanal atresia may be unilateral or bilateral, bony or membranous, complete or incomplete. In over 90 per cent of cases the obstruction is bony, while in the remainder it is membranous. The bony type of atresia is commonly located 1-2 mm. anterior to the posterior edge of the hard palate, and the osseous septum varies in thickness from 1 to 10 mm. In the membranous form of choanal atresia the obstruction usually occurs further posteriorly. In approximately one third of cases the atresia is bilateral. Evidence: TAS. Frequency: Very frequent (HP:0040281). (ORPHA:1555)
- Anteverted nares (HP:0000463): Anteriorly-facing nostrils viewed with the head in the Frankfurt horizontal and the eyes of the observer level with the eyes of the subject. This gives the appearance of an upturned nose (upturned nasal tip). Evidence: TAS. Frequency: Occasional (HP:0040283). (ORPHA:1555)
- Abnormality of the eye (HP:0000478): Any abnormality of the eye, including location, spacing, and intraocular abnormalities. Evidence: TAS. Frequency: Occasional (HP:0040283). (ORPHA:1555)
- Downslanted palpebral fissures (HP:0000494): The palpebral fissure inclination is more than two standard deviations below the mean. Evidence: TAS. Frequency: Very frequent (HP:0040281). (ORPHA:1555)
- Abnormality of vision (HP:0000504): Abnormality of eyesight (visual perception). Evidence: TAS. Frequency: Occasional (HP:0040283). (ORPHA:1555)
- Ptosis (HP:0000508): The upper eyelid margin is positioned 3 mm or more lower than usual and covers the superior portion of the iris (objective); or, the upper lid margin obscures at least part of the pupil (subjective). Evidence: TAS. Frequency: Very frequent (HP:0040281). (ORPHA:1555)
- Proptosis (HP:0000520): An eye that is protruding anterior to the plane of the face to a greater extent than is typical. Evidence: TAS. Frequency: Very frequent (HP:0040281). (ORPHA:1555)
- Optic atrophy (HP:0000648): Atrophy of the optic nerve. Optic atrophy results from the death of the retinal ganglion cell axons that comprise the optic nerve and manifesting as a pale optic nerve on fundoscopy. Evidence: TAS. Frequency: Occasional (HP:0040283). (ORPHA:1555)
- Hypertension (HP:0000822): The presence of chronic increased pressure in the systemic arterial system. Evidence: TAS. Frequency: Occasional (HP:0040283). (ORPHA:1555)
- Abnormal skull morphology (HP:0000929): An abnormality of the skull, the bony framework of the head which is comprised of the neurocranium (with eight cranial bones) and the viscerocranium (facial skeleton) that comprises fourteen facial bones with the mandible as its largest bone. Evidence: TAS. Frequency: Very frequent (HP:0040281). (ORPHA:1555)
- Acanthosis nigricans (HP:0000956): A dermatosis characterized by thickened, hyperpigmented plaques, typically on the intertriginous surfaces and neck. Evidence: TAS. Frequency: Very frequent (HP:0040281). (ORPHA:1555)
- Palmoplantar keratoderma (HP:0000982): Abnormal thickening of the skin of the palms of the hands and the soles of the feet. Evidence: TAS. Frequency: Very frequent (HP:0040281). (ORPHA:1555)
- Melanocytic nevus (HP:0000995): A oval and round, colored (usually medium-to dark brown, reddish brown, or flesh colored) lesion. Typically, a melanocytic nevus is less than 6 mm in diameter, but may be much smaller or larger. Evidence: TAS. Frequency: Very frequent (HP:0040281). (ORPHA:1555)
- Craniosynostosis (HP:0001363): Craniosynostosis refers to the premature closure of the cranial sutures. Primary craniosynostosis refers to the closure of one or more sutures due to abnormalities in skull development, and secondary craniosynostosis results from failure of brain growth. Evidence: TAS. Frequency: Frequent (HP:0040282). (ORPHA:1555)
- Subcutaneous nodule (HP:0001482): Slightly elevated lesions on or in the skin with a diameter of over 5 mm. Evidence: TAS. Frequency: Very frequent (HP:0040281). (ORPHA:1555)
- Umbilical hernia (HP:0001537): Protrusion of abdominal contents through a defect in the abdominal wall musculature around the umbilicus. Skin and subcutaneous tissue overlie the defect. Evidence: TAS. Frequency: Occasional (HP:0040283). (ORPHA:1555)
- Anteriorly placed anus (HP:0001545): Anterior malposition of the anus. Evidence: TAS. Frequency: Occasional (HP:0040283). (ORPHA:1555)
- Abnormal nail morphology (HP:0001597): Abnormal structure or appearance of the nail. Evidence: TAS. Frequency: Occasional (HP:0040283). (ORPHA:1555)
- Abnormality of the pancreas (HP:0001732): An abnormality of the pancreas. Evidence: TAS. Frequency: Very frequent (HP:0040281). (ORPHA:1555)
- Respiratory distress (HP:0002098): Respiratory distress is objectively observable as the physical or emotional consequences from the experience of dyspnea. The physical presentation of respiratory distress is generally referred to as labored breathing, while the sensation of respiratory distress is called shortness of breath or dyspnea. Evidence: TAS. Frequency: Very frequent (HP:0040281). (ORPHA:1555)
- Cloverleaf skull (HP:0002676): Trilobar skull configuration when viewed from the front or behind. Evidence: TAS. Frequency: Very frequent (HP:0040281). (ORPHA:1555)
- Prominent scrotal raphe (HP:0003246): Increased size of the ridge of tissue that extends along the midline of the scrotum. Evidence: TAS. Frequency: Frequent (HP:0040282). (ORPHA:1555)
- Preauricular skin furrow (HP:0004450): A groove of the skin immediately in front of the ear. Evidence: TAS. Frequency: Very frequent (HP:0040281). (ORPHA:1555)
- Depressed nasal bridge (HP:0005280): Posterior positioning of the nasal root in relation to the overall facial profile for age. Evidence: TAS. Frequency: Very frequent (HP:0040281). (ORPHA:1555)
- Palmoplantar cutis gyrata (HP:0007469): Cutis gyrata of palms and soles. Evidence: TAS. Frequency: Very frequent (HP:0040281). (ORPHA:1555)
- Tooth agenesis (HP:0009804): The absence of one or more teeth from the normal series by a failure to develop. Evidence: TAS. Frequency: Very frequent (HP:0040281). (ORPHA:1555)
- Aplasia/Hypoplasia of the earlobes (HP:0009906): Absence or underdevelopment of the ear lobes. Evidence: TAS. Frequency: Very frequent (HP:0040281). (ORPHA:1555)
- Hypoplasia of the zygomatic bone (HP:0010669): Underdevelopment of the zygomatic bone. That is, a reduction in size of the zygomatic bone, including the zygomatic process of the temporal bone of the skull, which forms part of the zygomatic arch. Evidence: TAS. Frequency: Very frequent (HP:0040281). (ORPHA:1555)
- Midface retrusion (HP:0011800): Posterior positions and/or vertical shortening of the infraorbital and perialar regions, or increased concavity of the face and/or reduced nasolabial angle. Evidence: TAS. Frequency: Very frequent (HP:0040281). (ORPHA:1555)
- Visceral angiomatosis (HP:0100761). Evidence: TAS. Frequency: Very frequent (HP:0040281). (ORPHA:1555)
These phenotypes are associated with the disease Cutis gyrata-acanthosis nigricans-craniosynostosis syndrome (ORPHA:1555).